Phenotypes associated with the disease portal hypertension, noncirrhotic, 1 (OMIM:617068):
- Portal hypertension (HP:0001409): Increased pressure in the portal vein. Evidence: PCS. Frequency: 8/8. (PMID:26874653)
- Hepatomegaly (HP:0002240): Abnormally increased size of the liver. Evidence: PCS. Frequency: 1/8. (PMID:26874653)
- Autosomal recessive inheritance (HP:0000007): A mode of inheritance that is observed for traits related to a gene encoded on one of the autosomes (i.e., the human chromosomes 1-22) in which a trait manifests in individuals with two pathogenic alleles, either homozygotes (two copies of the same mutant allele) or compound heterozygotes (whereby each copy of a gene has a distinct mutant allele). Evidence: PCS. (PMID:26874653)
- Esophageal varix (HP:0002040): Extreme dilation of the submucusoal veins in the lower portion of the esophagus. Evidence: PCS. Frequency: 7/8. (PMID:26874653)
- Elevated circulating hepatic transaminase concentration (HP:0002910): Elevations of the levels of SGOT and SGPT in the serum. SGOT (serum glutamic oxaloacetic transaminase) and SGPT (serum glutamic pyruvic transaminase) are transaminases primarily found in the liver and heart and are released into the bloodstream as the result of liver or heart damage. SGOT and SGPT are used clinically mainly as markers of liver damage. Evidence: PCS. Frequency: 1/8. (PMID:26874653)
- Splenomegaly (HP:0001744): Abnormal increased size of the spleen. Evidence: PCS. Frequency: 8/8. (PMID:26874653)